- Incoordination (HP:0002311): A deficit in coordination of muscle movements. Coordination is defined as the orchestrated movement of multiple body parts as required to accomplish intended actions, like walking. Evidence: TAS. (OMIM:258800)
- Autosomal recessive inheritance (HP:0000007): A mode of inheritance that is observed for traits related to a gene encoded on one of the autosomes (i.e., the human chromosomes 1-22) in which a trait manifests in individuals with two pathogenic alleles, either homozygotes (two copies of the same mutant allele) or compound heterozygotes (whereby each copy of a gene has a distinct mutant allele). Evidence: TAS. (OMIM:258800)
- Drooling (HP:0002307): Habitual flow of saliva out of the mouth. Evidence: TAS. (OMIM:258800)
These phenotypes are associated with the disease oral sensibility, disturbance of (OMIM:258800).